Phenotypes associated with the disease Inherited epidermodysplasia verruciformis (ORPHA:302):
- Seborrheic dermatitis (HP:0001051): Seborrheic dermatitis is a form of eczema which is closely related to dandruff. It causes dry or greasy peeling of the scalp, eyebrows, and face, and sometimes trunk. Evidence: TAS. Frequency: Very frequent (HP:0040281). (ORPHA:302)
- Hypopigmented skin patches (HP:0001053). Evidence: TAS. Frequency: Frequent (HP:0040282). (ORPHA:302)
- Recurrent skin infections (HP:0001581): Infections of the skin that happen multiple times. Evidence: TAS. Frequency: Very frequent (HP:0040281). (ORPHA:302)
- Abnormality of the immune system (HP:0002715): An abnormality of the immune system. Evidence: TAS. Frequency: Very frequent (HP:0040281). (ORPHA:302)
- Squamous cell carcinoma (HP:0002860): The presence of squamous cell carcinoma of the skin. Evidence: TAS. Frequency: Occasional (HP:0040283). (ORPHA:302)
- Multiple cafe-au-lait spots (HP:0007565): The presence of six or more cafe-au-lait spots. Evidence: TAS. Frequency: Frequent (HP:0040282). (ORPHA:302)
- Telangiectasia of the skin (HP:0100585): Presence of small, permanently dilated blood vessels near the surface of the skin, visible as small focal red lesions. Evidence: TAS. Frequency: Occasional (HP:0040283). (ORPHA:302)
- Papule (HP:0200034): A circumscribed, solid elevation of skin with no visible fluid, varying in size from a pinhead to less than 10mm in diameter at the widest point. Evidence: TAS. Frequency: Very frequent (HP:0040281). (ORPHA:302)
- Skin plaque (HP:0200035): A plaque is a solid, raised, plateau-like (flat-topped) lesion greater than 1 cm in diameter. Evidence: TAS. Frequency: Very frequent (HP:0040281). (ORPHA:302)
- Pustule (HP:0200039): A small elevation of the skin containing cloudy or purulent material usually consisting of necrotic inflammatory cells. Evidence: TAS. Frequency: Very frequent (HP:0040281). (ORPHA:302)
- Verrucae (HP:0200043): Warts, benign growths on the skin or mucous membranes that cause cosmetic problems as well as pain and discomfort. Warts most often occur on the hands, feet, and genital areas. Evidence: TAS. Frequency: Very frequent (HP:0040281). (ORPHA:302)